- Menorrhagia (HP:0000132): Prolonged and excessive menses at regular intervals in excess of 80 mL or lasting longer than 7 days. Evidence: TAS. (OMIM:176630)
- Abnormal bleeding (HP:0001892): An abnormal susceptibility to bleeding, often referred to as a bleeding diathesis. A bleeding diathesis may be related to vascular, platelet and coagulation defects. Evidence: TAS. (OMIM:176630)
- Bruising susceptibility (HP:0000978): An ecchymosis (bruise) refers to the skin discoloration caused by the escape of blood into the tissues from ruptured blood vessels. This term refers to an abnormally increased susceptibility to bruising. The corresponding phenotypic abnormality is generally elicited on medical history as a report of frequent ecchymoses or bruising without adequate trauma. Evidence: TAS. (OMIM:176630)
- Spontaneous, recurrent epistaxis (HP:0004406). Evidence: TAS. (OMIM:176630)
- Autosomal dominant inheritance (HP:0000006): A mode of inheritance that is observed for traits related to a gene encoded on one of the autosomes (i.e., the human chromosomes 1-22) in which a trait manifests in heterozygotes. In the context of medical genetics, an autosomal dominant disorder is caused when a single copy of the mutant allele is present. Males and females are affected equally, and can both transmit the disorder with a risk of 50% for each child of inheriting the mutant allele. Evidence: TAS. (OMIM:176630)
These phenotypes are associated with the disease primary release disorder of platelets (OMIM:176630).